- Progressive neurologic deterioration (HP:0002344). Evidence: PCS. Frequency: 7/7. (PMID:27435091)
- Bilateral tonic-clonic seizure (HP:0002069): A bilateral tonic-clonic seizure is a seizure defined by a tonic (bilateral increased tone, lasting seconds to minutes) and then a clonic (bilateral sustained rhythmic jerking) phase. Evidence: PCS. Frequency: 4/7. (PMID:27435091)
- Elevated circulating creatine kinase activity (HP:0003236): The activity of creatine kinase in the blood circulation is above the upper limit of normal. Evidence: PCS. Frequency: 2/2. (PMID:27435091)
- Hypsarrhythmia (HP:0002521): Hypsarrhythmia is abnormal interictal high amplitude waves and a background of irregular spikes. There is continuous (during wakefulness), high-amplitude (>200 Hz), generalized polymorphic slowing with no organized background and multifocal spikes demonstrated by electroencephalography (EEG). Evidence: PCS. Frequency: 3/7. (PMID:27435091)
- Spastic tetraplegia (HP:0002510): Spastic paralysis affecting all four limbs. Evidence: PCS. Frequency: 5/7. (PMID:27435091)
- Dystonia (HP:0001332): An abnormally increased muscular tone that causes fixed abnormal postures. There is a slow, intermittent twisting motion that leads to exaggerated turning and posture of the extremities and trunk. Evidence: PCS. Frequency: 2/6. (PMID:27435091)
- Feeding difficulties (HP:0011968): Impaired ability to eat related to problems gathering food and getting ready to suck, chew, or swallow it. Evidence: PCS. Frequency: 7/7. (PMID:27435091)
- Seizure (HP:0001250): A seizure is an intermittent abnormality of nervous system physiology characterized by a transient occurrence of signs and/or symptoms due to abnormal excessive or synchronous neuronal activity in the brain. Evidence: PCS. Frequency: 7/7. (PMID:27435091)
- Profound intellectual disability (HP:0002187): Profound intellectual disability (ID) is defined as a type of ID characterized by profoundly sub-average adaptive functioning and intellectual functioning, with an intelligence quotient (IQ) below 20. Evidence: PCS. Frequency: 7/7. (PMID:27435091)
- Increased circulating lactate concentration (HP:0002151): Abnormally increased level of blood lactate (2-hydroxypropanoic acid). Lactate is produced from pyruvate by lactate dehydrogenase during normal metabolism. The terms lactate and lactic acid are often used interchangeably but lactate (the component measured in blood) is strictly a weak base whereas lactic acid is the corresponding acid. Lactic acidosis is often used clinically to describe elevated lactate but should be reserved for cases where there is a corresponding acidosis (pH below 7.35). Evidence: TAS. (OMIM:617389)
- Global developmental delay (HP:0001263): A delay in the achievement of motor or mental milestones in the domains of development of a child, including motor skills, speech and language, cognitive skills, and social and emotional skills. This term should only be used to describe children younger than five years of age. Evidence: PCS. Frequency: 2/2. (PMID:27435091)
- Hypotonia (HP:0001252): Hypotonia is an abnormally low muscle tone (the amount of tension or resistance to movement in a muscle). Even when relaxed, muscles have a continuous and passive partial contraction which provides some resistance to passive stretching. Hypotonia thus manifests as diminished resistance to passive stretching. Hypotonia is not the same as muscle weakness, although the two conditions can co-exist. Evidence: PCS. Frequency: 6/7. (PMID:27435091)
- Infantile onset (HP:0003593): Onset of signs or symptoms of disease between 28 days to one year of life. Evidence: PCS. Frequency: 2/7. (PMID:27435091)
- Myoclonic seizure (HP:0032794): A myoclonic seizure is a type of motor seizure characterized by sudden, brief (<100 ms) involuntary single or multiple contraction of muscles or muscle groups of variable topography (axial, proximal limb, distal). Myoclonus is less regularly repetitive and less sustained than is clonus. Evidence: PCS. Frequency: 6/7. (PMID:27435091)
- Thin corpus callosum (HP:0033725): An abnormally thin corpus callous, due to atrophy, hypoplasia or agenesis. This term is intended to be used in situations where it is not known if thinning of the corpus callosum (for instance, as visualized by magnetic resonance tomography) is due to abnormal development (e.g. a leukodystrophy) or atrophy following normal development (e.g. neurodegeneration). Evidence: PCS. Frequency: 1/7. (PMID:27435091)
- Epileptic spasm (HP:0011097): A sudden flexion, extension, or mixed extension-flexion of predominantly proximal and truncal muscles that is usually more sustained than a myoclonic movement but not as sustained as a tonic seizure. Limited forms may occur: Grimacing, head nodding, or subtle eye movements. Epileptic spasms frequently occur in clusters. Infantile spasms are the best known form, but spasms can occur at all ages. Evidence: PCS. Frequency: 2/7. (PMID:27435091)
- Tonic seizure (HP:0032792): A tonic seizure is a type of motor seizure characterized by unilateral or bilateral limb stiffening or elevation, often with neck stiffening. Evidence: PCS. Frequency: 4/7. (PMID:27435091)
- Convulsive status epilepticus (HP:0032660): A type of status epilepticus characterized by a prolonged bilateral tonic-clonic seizure, or repeated bilateral tonic-clonic seizures without recovery between. Evidence: PCS. Frequency: 1/7. (PMID:27435091)
- Autosomal recessive inheritance (HP:0000007): A mode of inheritance that is observed for traits related to a gene encoded on one of the autosomes (i.e., the human chromosomes 1-22) in which a trait manifests in individuals with two pathogenic alleles, either homozygotes (two copies of the same mutant allele) or compound heterozygotes (whereby each copy of a gene has a distinct mutant allele). Evidence: PCS. (PMID:27435091)
- Epileptic encephalopathy (HP:0200134): A condition in which epileptiform abnormalities are believed to contribute to the progressive disturbance in cerebral function. Epileptic encephalaopathy is characterized by (1) electrographic EEG paroxysmal activity that is often aggressive, (2) seizures that are usually multiform and intractable, (3) cognitive, behavioral and neurological deficits that may be relentless, and (4) sometimes early death. Evidence: PCS. Frequency: 7/7. (PMID:27435091)
- Visual impairment (HP:0000505): Visual impairment (or vision impairment) is vision loss (of a person) to such a degree as to qualify as an additional support need through a significant limitation of visual capability resulting from either disease, trauma, or congenital or degenerative conditions that cannot be corrected by conventional means, such as refractive correction, medication, or surgery. Evidence: PCS. Frequency: 3/7. (PMID:27435091)
- Neonatal onset (HP:0003623): Onset of signs or symptoms of disease within the first 28 days of life. Evidence: PCS. Frequency: 5/7. (PMID:27435091)
These phenotypes are associated with the disease developmental and epileptic encephalopathy, 53 (OMIM:617389).